Phenotypes associated with the disease Polydactyly-myopia syndrome (ORPHA:2917):
- Myopia (HP:0000545): An abnormality of refraction characterized by the ability to see objects nearby clearly, while objects in the distance appear blurry. Evidence: TAS. Frequency: Very frequent (HP:0040281). (ORPHA:2917)
- Postaxial hand polydactyly (HP:0001162): Supernumerary digits located at the ulnar side of the hand (that is, on the side with the fifth finger). Evidence: TAS. Frequency: Very frequent (HP:0040281). (ORPHA:2917)
- Inguinal hernia (HP:0000023): Protrusion of the contents of the abdominal cavity through the inguinal canal. Evidence: TAS. Frequency: Frequent (HP:0040282). (ORPHA:2917)
- Cryptorchidism (HP:0000028): Testis in inguinal canal. That is, absence of one or both testes from the scrotum owing to failure of the testis or testes to descend through the inguinal canal to the scrotum. Evidence: TAS. Frequency: Frequent (HP:0040282). (ORPHA:2917)
- Femoral hernia (HP:0100541): A hernia which occurs just below the inguinal ligament, where abdominal contents pass through a naturally occurring weakness called the femoral canal. Evidence: TAS. Frequency: Frequent (HP:0040282). (ORPHA:2917)